Phenotypes associated with the disease Spinocerebellar ataxia type 19/22 (ORPHA:98772):
- Gait disturbance (HP:0001288): The term gait disturbance can refer to any disruption of the ability to walk. Evidence: TAS. Frequency: Very frequent (HP:0040281). (ORPHA:98772)
- Ataxia (HP:0001251): Ataxia refers to impaired coordination of voluntary muscle movement. Cerebellar ataxia refers to ataxia due to dysfunction of the cerebellum. This causes a variety of elementary neurological deficits including asynergy (lack of coordination between muscles, limbs and joints), dysmetria (lack of ability to judge distances that can lead to under- or overshoot in grasping movements), and dysdiadochokinesia (inability to perform rapid movements requiring antagonizing muscle groups to be switched on and off repeatedly). Evidence: TAS. Frequency: Very frequent (HP:0040281). (ORPHA:98772)
- Urinary incontinence (HP:0000020): Loss of the ability to control the urinary bladder leading to involuntary urination. Evidence: TAS. Frequency: Frequent (HP:0040282). (ORPHA:98772)
- Hyporeflexia (HP:0001265): Reduction of neurologic reflexes such as the knee-jerk reaction. Evidence: TAS. Frequency: Frequent (HP:0040282). (ORPHA:98772)
- Cerebellar atrophy (HP:0001272): Cerebellar atrophy is defined as a cerebellum with initially normal structures, in a posterior fossa with normal size, which displays enlarged fissures (interfolial spaces) in comparison to the foliae secondary to loss of tissue. Cerebellar atrophy implies irreversible loss of tissue and result from an ongoing progressive disease until a final stage is reached or a single injury, e.g. an intoxication or infectious event. Evidence: TAS. Frequency: Frequent (HP:0040282). (ORPHA:98772)
- Hyperreflexia (HP:0001347): Hyperreflexia is the presence of hyperactive stretch reflexes of the muscles. Evidence: TAS. Frequency: Frequent (HP:0040282). (ORPHA:98772)
- Limb ataxia (HP:0002070): A kind of ataxia that affects movements of the extremities. Evidence: TAS. Frequency: Frequent (HP:0040282). (ORPHA:98772)
- Truncal ataxia (HP:0002078): Truncal ataxia is a sign of ataxia characterized by instability of the trunk. It usually occurs during sitting. Evidence: TAS. Frequency: Frequent (HP:0040282). (ORPHA:98772)
- Postural instability (HP:0002172): A tendency to fall or the inability to keep oneself from falling; imbalance. The retropulsion test is widely regarded as the gold standard to evaluate postural instability, Use of the retropulsion test includes a rapid balance perturbation in the backward direction, and the number of balance correcting steps (or total absence thereof) is used to rate the degree of postural instability. Healthy subjects correct such perturbations with either one or two large steps, or without taking any steps, hinging rapidly at the hips while swinging the arms forward as a counterweight. In patients with balance impairment, balance correcting steps are often too small, forcing patients to take more than two steps. Taking three or more steps is generally considered to be abnormal, and taking more than five steps is regarded as being clearly abnormal. Markedly affected patients continue to step backward without ever regaining their balance and must be caught by the examiner (this would be called true retropulsion). Even more severely affected patients fail to correct entirely, and fall backward like a pushed toy soldier, without taking any corrective steps. Evidence: TAS. Frequency: Frequent (HP:0040282). (ORPHA:98772)
- Impaired vibration sensation at ankles (HP:0006938): A decrease in the ability to perceive vibration at the ankles. Clinically, this is usually tested with a tuning fork which vibrates at 128 Hz and is applied to the malleoli of the ankles. Evidence: TAS. Frequency: Frequent (HP:0040282). (ORPHA:98772)
- Ophthalmoplegia (HP:0000602): Paralysis of one or more extraocular muscles that are responsible for eye movements. Evidence: TAS. Frequency: Occasional (HP:0040283). (ORPHA:98772)
- Nystagmus (HP:0000639): Rhythmic, involuntary oscillations of one or both eyes related to abnormality in fixation, conjugate gaze, or vestibular mechanisms. Evidence: TAS. Frequency: Occasional (HP:0040283). (ORPHA:98772)
- Diplopia (HP:0000651): Diplopia is a condition in which a single object is perceived as two images, it is also known as double vision. Evidence: TAS. Frequency: Occasional (HP:0040283). (ORPHA:98772)
- Dysarthria (HP:0001260): Dysarthric speech is a general description referring to a neurological speech disorder characterized by poor articulation. Depending on the involved neurological structures, dysarthria may be further classified as spastic, flaccid, ataxic, hyperkinetic and hypokinetic, or mixed. Evidence: TAS. Frequency: Occasional (HP:0040283). (ORPHA:98772)
- Slurred speech (HP:0001350): Abnormal coordination of muscles involved in speech. Evidence: TAS. Frequency: Occasional (HP:0040283). (ORPHA:98772)
- Broad-based gait (HP:0002136): An abnormal gait pattern in which persons stand and walk with their feet spaced widely apart. This is often a component of cerebellar ataxia. Evidence: TAS. Frequency: Occasional (HP:0040283). (ORPHA:98772)
- Incoordination (HP:0002311): A deficit in coordination of muscle movements. Coordination is defined as the orchestrated movement of multiple body parts as required to accomplish intended actions, like walking. Evidence: TAS. Frequency: Occasional (HP:0040283). (ORPHA:98772)
- Cogwheel rigidity (HP:0002396): A type of rigidity in which a muscle responds with cogwheellike jerks to the use of constant force in bending the limb (i.e., it gives way in little, repeated jerks when the muscle is passively stretched). Evidence: TAS. Frequency: Occasional (HP:0040283). (ORPHA:98772)
- Impaired smooth pursuit (HP:0007772): An impairment of the ability to track objects with the ocular smooth pursuit system, a class of rather slow eye movements that minimizes retinal target motion. Evidence: TAS. Frequency: Occasional (HP:0040283). (ORPHA:98772)